Phenotypes associated with the disease Sifrim-Hitz-Weiss syndrome (OMIM:617159):
- Hypogonadotropic hypogonadism (HP:0000044): Hypogonadotropic hypogonadism is characterized by reduced function of the gonads (testes in males or ovaries in females) and results from the absence of the gonadal stimulating pituitary hormones: follicle stimulating hormone (FSH) and luteinizing hormone (LH). Evidence: PCS. Frequency: 3/4. (PMID:27616479)
- Epicanthus (HP:0000286): A fold of skin starting above the medial aspect of the upper eyelid and arching downward to cover, pass in front of and lateral to the medial canthus. Evidence: PCS. (PMID:27479907)
- Upslanted palpebral fissure (HP:0000582): The palpebral fissure inclination is more than two standard deviations above the mean for age (objective); or, the inclination of the palpebral fissure is greater than typical for age. Evidence: TAS. (OMIM:617159)
- Astigmatism (HP:0000483): A type of refraction error associated with abnormal curvatures on the anterior and/or posterior surface of the cornea. Evidence: PCS. (PMID:27479907)
- Hearing impairment (HP:0000365): A decreased magnitude of the sensory perception of sound. Evidence: PCS. Frequency: 4/5. (PMID:27616479)
- Trigonocephaly (HP:0000243): Wedge-shaped, or triangular head, with the apex of the triangle at the midline of the forehead and the base of the triangle at the occiput. Evidence: TAS. (OMIM:617159)
- Short stature (HP:0004322): A height below that which is expected according to age and gender norms. Although there is no universally accepted definition of short stature, many refer to "short stature" as height more than 2 standard deviations below the mean for age and gender (or below the 3rd percentile for age and gender dependent norms). Evidence: PCS. Frequency: 1/5. (PMID:27616479)
- Ambiguous genitalia (HP:0000062): A genital phenotype that is not clearly assignable to a single gender. Ambiguous genitalia can be evaluated using the Prader scale: Prader 0: Normal female external genitalia. Prader 1: Female external genitalia with clitoromegaly. Prader 2: Clitoromegaly with partial labial fusion forming a funnel-shaped urogenital sinus. Prader 3: Increased phallic enlargement. Complete labioscrotal fusion forming a urogenital sinus with a single opening. Prader 4: Complete scrotal fusion with urogenital opening at the base or on the shaft of the phallus. Prader 5: Normal male external genitalia. The diagnosis of ambiguous genitalia is made for Prader 1-4. Evidence: PCS. (PMID:27479907)
- Renal insufficiency (HP:0000083): A reduction in the level of performance of the kidneys in areas of function comprising the concentration of urine, removal of wastes, the maintenance of electrolyte balance, homeostasis of blood pressure, and calcium metabolism. Evidence: PCS. Frequency: 1/5. (PMID:27616479)
- Hypotonia (HP:0001252): Hypotonia is an abnormally low muscle tone (the amount of tension or resistance to movement in a muscle). Even when relaxed, muscles have a continuous and passive partial contraction which provides some resistance to passive stretching. Hypotonia thus manifests as diminished resistance to passive stretching. Hypotonia is not the same as muscle weakness, although the two conditions can co-exist. Evidence: PCS. Frequency: 4/5. (PMID:27616479)
- Gait imbalance (HP:0002141). Evidence: PCS. Frequency: 1/5. (PMID:27479907)
- Short palpebral fissure (HP:0012745): Distance between the medial and lateral canthi is more than 2 SD below the mean for age (objective); or, apparently reduced length of the palpebral fissures. Evidence: TAS. (OMIM:617159)
- Coarse facial features (HP:0000280): Absence of fine and sharp appearance of brows, nose, lips, mouth, and chin, usually because of rounded and heavy features or thickened skin with or without thickening of subcutaneous and bony tissues. Evidence: PCS. (PMID:27479907)
- Short femoral neck (HP:0100864): An abnormally short femoral neck (which is the process of bone, connecting the femoral head with the femoral shaft). Evidence: PCS. (PMID:27479907)
- Ventricular septal defect (HP:0001629): A hole between the two bottom chambers (ventricles) of the heart. The defect is centered around the most superior aspect of the ventricular septum. Evidence: PCS. Frequency: 2/6. (PMID:27479907)
- Ventricular septal defect (HP:0001629): A hole between the two bottom chambers (ventricles) of the heart. The defect is centered around the most superior aspect of the ventricular septum. Evidence: PCS. Frequency: 2/5. Onset: Congenital onset (HP:0003577). (PMID:27616479)
- Hypertelorism (HP:0000316): Interpupillary distance more than 2 SD above the mean (alternatively, the appearance of an increased interpupillary distance or widely spaced eyes). Evidence: PCS. (PMID:27616479)
- Ventriculomegaly (HP:0002119): An increase in size of the ventricular system of the brain. Evidence: PCS. Frequency: 5/5. (PMID:27616479)
- Patent ductus arteriosus (HP:0001643): In utero, the ductus arteriosus (DA) serves to divert ventricular output away from the lungs and toward the placenta by connecting the main pulmonary artery to the descending aorta. A patent ductus arteriosus (PDA) in the first 3 days of life is a physiologic shunt in healthy term and preterm newborn infants, and normally is substantially closed within about 24 hours after bith and completely closed after about three weeks. Failure of physiologcal closure is referred to a persistent or patent ductus arteriosus (PDA). Depending on the degree of left-to-right shunting, PDA can have clinical consequences. Evidence: PCS. Frequency: 2/5. Onset: Congenital onset (HP:0003577). (PMID:27616479)
- Cupped ear (HP:0000378): Laterally protruding ear that lacks antihelical folding (including absence of inferior and superior crura). Evidence: PCS. (PMID:27616479)
- Short clavicles (HP:0000894): Reduced length of the clavicles. Evidence: PCS. Frequency: 1/6. (PMID:27479907)
- Macrocephaly (HP:0000256): Occipitofrontal (head) circumference greater than 97th centile compared to appropriate, age matched, sex-matched normal standards. Alternatively, a apparently increased size of the cranium. Evidence: PCS. Frequency: 4/5. (PMID:27616479)
- Intellectual disability (HP:0001249): The term intellectual disability or intellectual developmental disorder is used to describe significantly sub-average intellectual and adaptive functioning based on clinical assessment and as measured by individually administered, appropriately normed, standardized and validated tests of intellectual functioning and adaptive behavior, with onset during the developmental period from infancy through adolescence. Evidence: PCS. Frequency: 5/5. (PMID:27616479)
- Small foramen magnum (HP:0002677): An abnormal narrowing of the foramen magnum. Evidence: PCS. Frequency: 1/5. (PMID:27616479)
- Anteriorly placed anus (HP:0001545): Anterior malposition of the anus. Evidence: PCS. (PMID:27616479)
- Vesicoureteral reflux (HP:0000076): Abnormal (retrograde) movement of urine from the bladder into ureters or kidneys related to inadequacy of the valvular mechanism at the ureterovesicular junction or other causes. Evidence: PCS. (PMID:27479907)
- Micropenis (HP:0000054): Abnormally small penis. At birth, the normal penis is about 3 cm (stretched length from pubic tubercle to tip of penis) with micropenis less than 2.0-2.5 cm. Evidence: PCS. Frequency: 3/3. (PMID:27616479)
- Bifid uvula (HP:0000193): Uvula separated into two parts most easily seen at the tip. Evidence: PCS. Frequency: 1/5. (PMID:27616479)
- Global developmental delay (HP:0001263): A delay in the achievement of motor or mental milestones in the domains of development of a child, including motor skills, speech and language, cognitive skills, and social and emotional skills. This term should only be used to describe children younger than five years of age. Evidence: PCS. Frequency: 5/5. (PMID:27616479)
- Coarctation of aorta (HP:0001680): Coarctation of the aorta is a narrowing or constriction of a segment of the aorta. Evidence: PCS. Frequency: 1/6. (PMID:27479907)
- Tapered finger (HP:0001182): The gradual reduction in girth of the finger from proximal to distal. Evidence: TAS. (OMIM:617159)
- Flat acetabular roof (HP:0003180): Flattening of the superior part of the acetabulum, which is a cup-shaped cavity at the base of the hipbone into which the ball-shaped head of the femur fits. The acetabular roof thereby appears horizontal rather than arched, as it normally does. Evidence: TAS. (OMIM:617159)
- Ptosis (HP:0000508): The upper eyelid margin is positioned 3 mm or more lower than usual and covers the superior portion of the iris (objective); or, the upper lid margin obscures at least part of the pupil (subjective). Evidence: PCS. (PMID:27479907)
- Fused cervical vertebrae (HP:0002949): A congenital anomaly characterized by a joining (fusion) of two or more cervical vertebral bodies with one another. Evidence: PCS. Frequency: 2/5. (PMID:27616479)
- Tetralogy of Fallot (HP:0001636): A congenital cardiac malformation comprising pulmonary stenosis, overriding aorta, ventricular septum defect, and right ventricular hypertrophy. The diagnosis of TOF is made if at least three of the four above mentioned features are present. Evidence: PCS. Frequency: 3/5. (PMID:27479907)
- Chiari malformation (HP:0002308): Chiari malformation consists of a downward displacement of the cerebellar tonsils and the medulla through the foramen magnum, sometimes causing hydrocephalus as a result of obstruction of CSF outflow. Evidence: PCS. Frequency: 1/5. (PMID:27616479)
- Wormian bones (HP:0002645): The presence of extra bones within a cranial suture. Wormian bones are irregular isolated bones which appear in addition to the usual centers of ossification of the cranium. Evidence: PCS. Frequency: 1/5. (PMID:27479907)
- Atrial septal defect (HP:0001631): Atrial septal defect (ASD) is a congenital abnormality of the interatrial septum that enables blood flow between the left and right atria via the interatrial septum. Evidence: PCS. Frequency: 2/6. (PMID:27479907)
- Atrial septal defect (HP:0001631): Atrial septal defect (ASD) is a congenital abnormality of the interatrial septum that enables blood flow between the left and right atria via the interatrial septum. Evidence: PCS. Frequency: 2/5. Onset: Congenital onset (HP:0003577). (PMID:27616479)
- Low-set ears (HP:0000369): Upper insertion of the ear to the scalp below an imaginary horizontal line drawn between the inner canthi of the eye and extending posteriorly to the ear. Evidence: PCS. (PMID:27616479)
- Cryptorchidism (HP:0000028): Testis in inguinal canal. That is, absence of one or both testes from the scrotum owing to failure of the testis or testes to descend through the inguinal canal to the scrotum. Evidence: PCS. Frequency: 2/3. (PMID:27616479)
- Autosomal dominant inheritance (HP:0000006): A mode of inheritance that is observed for traits related to a gene encoded on one of the autosomes (i.e., the human chromosomes 1-22) in which a trait manifests in heterozygotes. In the context of medical genetics, an autosomal dominant disorder is caused when a single copy of the mutant allele is present. Males and females are affected equally, and can both transmit the disorder with a risk of 50% for each child of inheriting the mutant allele. Evidence: PCS. (PMID:27616479)